- Constriction of peripheral visual field (HP:0001133): An absolute or relative decrease in retinal sensitivity extending from edge (periphery) of the visual field in a concentric pattern. The visual field is the area that is perceived simultaneously by a fixating eye. Evidence: TAS. (OMIM:610535)
- Open angle glaucoma (HP:0012108): A type of glaucoma defined by an open, normal appearing anterior chamber angle and raised intraocular pressure,. Evidence: TAS. (OMIM:610535)
- Autosomal dominant inheritance (HP:0000006): A mode of inheritance that is observed for traits related to a gene encoded on one of the autosomes (i.e., the human chromosomes 1-22) in which a trait manifests in heterozygotes. In the context of medical genetics, an autosomal dominant disorder is caused when a single copy of the mutant allele is present. Males and females are affected equally, and can both transmit the disorder with a risk of 50% for each child of inheriting the mutant allele. Evidence: TAS. (OMIM:610535)
These phenotypes are associated with the disease glaucoma 1, open angle, M (OMIM:610535).